- Microcephaly (HP:0000252): Head circumference below 2 standard deviations below the mean for age and gender. Evidence: IEA. (OMIM:225700)
- Spastic diplegia (HP:0001264): Spasticity (neuromuscular hypertonia) primarily in the muscles of the legs, hips, and pelvis. Evidence: IEA. (OMIM:225700)
- Encephalomalacia (HP:0040197): Encephalomalacia is the softening or loss of brain tissue after cerebral infarction, cerebral ischemia, infection, craniocerebral trauma, or other injury. Evidence: IEA. (OMIM:225700)
- Autosomal recessive inheritance (HP:0000007): A mode of inheritance that is observed for traits related to a gene encoded on one of the autosomes (i.e., the human chromosomes 1-22) in which a trait manifests in individuals with two pathogenic alleles, either homozygotes (two copies of the same mutant allele) or compound heterozygotes (whereby each copy of a gene has a distinct mutant allele). Evidence: IEA. (OMIM:225700)
- Intellectual disability (HP:0001249): The term intellectual disability or intellectual developmental disorder is used to describe significantly sub-average intellectual and adaptive functioning based on clinical assessment and as measured by individually administered, appropriately normed, standardized and validated tests of intellectual functioning and adaptive behavior, with onset during the developmental period from infancy through adolescence. Evidence: IEA. (OMIM:225700)
These phenotypes are associated with the disease encephalomalacia, multilocular (OMIM:225700).